- Congenital onset (HP:0003577): A phenotypic abnormality that is present at birth. Evidence: PCS. Frequency: 2/5. (PMID:15596564)
- Third trimester onset (HP:0034197): This term refers to a phenotypic feature that was first observed prior to birth during the third trimester, which is defined as 28 weeks and zero days (28+0) of gestation and beyond. Evidence: PCS. Frequency: 3/5. (PMID:15596564)
- Left atrial enlargement (HP:0031295): Increase in size of the left atrium. Evidence: PCS. Frequency: 1/5. (PMID:15596564)
- Atrial fibrillation (HP:0005110): An atrial arrhythmia characterized by disorganized atrial activity without discrete P waves on the surface EKG, but instead by an undulating baseline or more sharply circumscribed atrial deflections of varying amplitude an frequency ranging from 350 to 600 per minute. Evidence: PCS. Frequency: 5/5. (PMID:15596564)
- Autosomal recessive inheritance (HP:0000007): A mode of inheritance that is observed for traits related to a gene encoded on one of the autosomes (i.e., the human chromosomes 1-22) in which a trait manifests in individuals with two pathogenic alleles, either homozygotes (two copies of the same mutant allele) or compound heterozygotes (whereby each copy of a gene has a distinct mutant allele). Evidence: PCS. (PMID:19070573)
- Atrial flutter (HP:0004749): A type of atrial arrhythmia characterized by atrial rates of between 240 and 400 beats per minute and some degree of atrioventricular node conduction block. Typically, the ventricular rate is half the atrial rate. In the EKG; atrial flutter waves are observed as sawtooth-like atrial activity. Pathophysiologically, atrial flutter is a form of atrial reentry in which there is a premature electrical impulse creates a self-propagating circuit. Evidence: PCS. Frequency: 2/5. (PMID:15596564)
- Sudden cardiac death (HP:0001645): The heart suddenly and unexpectedly stops beating resulting in death within a short time period (generally within 1 h of symptom onset). Evidence: PCS. Frequency: 2/5. (PMID:15596564)
- Supraventricular tachycardia (HP:0004755): Supraventricular tachycardia (SVT) is an abnormally increased heart rate (over 100 beats per minute at rest) with origin above the level of the ventricles. Evidence: PCS. Frequency: 3/5. (PMID:15596564)
These phenotypes are associated with the disease atrial fibrillation, familial, 15 (OMIM:615770).